Phenotypes associated with the disease facial paresis, hereditary congenital, 2 (OMIM:604185):
- Facial palsy (HP:0010628): Facial nerve palsy is a dysfunction of cranial nerve VII (the facial nerve) that results in inability to control facial muscles on the affected side with weakness of the muscles of facial expression and eye closure. This can either be present in unilateral or bilateral form. Evidence: IEA. (OMIM:604185)
- Hearing impairment (HP:0000365): A decreased magnitude of the sensory perception of sound. Evidence: IEA. (OMIM:604185)
- Nonprogressive (HP:0003680): Applies to a disease manifestation that does not increase in scope or severity over the course of time, i.e., that does not worsen with age. Evidence: IEA. (OMIM:604185)
- Autosomal dominant inheritance (HP:0000006): A mode of inheritance that is observed for traits related to a gene encoded on one of the autosomes (i.e., the human chromosomes 1-22) in which a trait manifests in heterozygotes. In the context of medical genetics, an autosomal dominant disorder is caused when a single copy of the mutant allele is present. Males and females are affected equally, and can both transmit the disorder with a risk of 50% for each child of inheriting the mutant allele. Evidence: IEA. (OMIM:604185)